Phenotypes associated with the disease megalencephaly, autosomal dominant (OMIM:155350):
- Megalencephaly (HP:0001355): Diffuse enlargement of the entire cerebral hemispheres leading to macrocephaly (with or without overlying cortical dysplasia). Evidence: PCS. Frequency: Obligate (HP:0040280). (PMID:7274594)
- Hydrocephalus (HP:0000238): Hydrocephalus is an active distension of the ventricular system of the brain resulting from inadequate passage of CSF from its point of production within the cerebral ventricles to its point of absorption into the systemic circulation. Evidence: PCS. Frequency: 2/10. (PMID:4855950)
- Macrocephaly (HP:0000256): Occipitofrontal (head) circumference greater than 97th centile compared to appropriate, age matched, sex-matched normal standards. Alternatively, a apparently increased size of the cranium. Evidence: PCS. (PMID:7274594)
- Autosomal dominant inheritance (HP:0000006): A mode of inheritance that is observed for traits related to a gene encoded on one of the autosomes (i.e., the human chromosomes 1-22) in which a trait manifests in heterozygotes. In the context of medical genetics, an autosomal dominant disorder is caused when a single copy of the mutant allele is present. Males and females are affected equally, and can both transmit the disorder with a risk of 50% for each child of inheriting the mutant allele. Evidence: PCS. (PMID:7274594)
- Intellectual disability (HP:0001249): The term intellectual disability or intellectual developmental disorder is used to describe significantly sub-average intellectual and adaptive functioning based on clinical assessment and as measured by individually administered, appropriately normed, standardized and validated tests of intellectual functioning and adaptive behavior, with onset during the developmental period from infancy through adolescence. Evidence: PCS. Frequency: 7/109. (PMID:7274594)